- Curly hair (HP:0002212). Evidence: PCS. Frequency: 1/1. (PMID:27866708)
- Pili canaliculi (HP:0002235): A characteristic triangular, kidney- or heat-shaped diameter of hair shafts with typical longitudinal canalicular deformation as observable by scanning electron microscopy. Evidence: PCS. Frequency: 1/1. (PMID:27866708)
- Brittle hair (HP:0002299): Fragile, easily breakable hair, i.e., with reduced tensile strength. Evidence: PCS. Frequency: 1/1. (PMID:27866708)
- Childhood onset (HP:0011463): Onset of disease at the age of between 1 and 5 years. Evidence: PCS. Frequency: 1/1. (PMID:27866708)
- Uncombable hair (HP:0030056): Hair that is disorderly, stands out from the scalp, and cannot be combed flat. Evidence: PCS. Frequency: 1/1. (PMID:27866708)
- Autosomal recessive inheritance (HP:0000007): A mode of inheritance that is observed for traits related to a gene encoded on one of the autosomes (i.e., the human chromosomes 1-22) in which a trait manifests in individuals with two pathogenic alleles, either homozygotes (two copies of the same mutant allele) or compound heterozygotes (whereby each copy of a gene has a distinct mutant allele). Evidence: PCS. (PMID:27866708)
These phenotypes are associated with the disease uncombable hair syndrome 3 (OMIM:617252).